Phenotypes associated with the disease arrhythmogenic right ventricular dysplasia 13 (OMIM:615616):
- Juvenile onset (HP:0003621): Onset of signs or symptoms of disease between the age of 5 and 15 years. Evidence: PCS. Frequency: 2/2. (PMID:23136403)
- First degree atrioventricular block (HP:0011705): Delay of conduction through the atrioventricular node, which is manifested as prolongation of the PR interval in the electrocardiogram (EKG). All atrial impulses reach the ventricles. Evidence: PCS. Frequency: 1/5. (PMID:23136403)
- Right ventricular dilatation (HP:0005133): Enlargement of the chamber of the right ventricle, which can be defined echocardiographically as a right ventricular to left ventricular ratio greater than 1:1. Evidence: PCS. Frequency: 2/5. (PMID:23136403)
- Left bundle branch block (HP:0011713): A conduction block of the left branch of the bundle of His. This manifests as a generalized disturbance of QRS morphology on EKG. Evidence: PCS. Frequency: 2/5. (PMID:23136403)
- Ventricular tachycardia (HP:0004756): A tachycardia originating in the ventricles characterized by rapid heart rate (over 100 beats per minute) and broad QRS complexes (over 120 ms). Evidence: PCS. Frequency: 2/5. (PMID:23136403)
- Autosomal dominant inheritance (HP:0000006): A mode of inheritance that is observed for traits related to a gene encoded on one of the autosomes (i.e., the human chromosomes 1-22) in which a trait manifests in heterozygotes. In the context of medical genetics, an autosomal dominant disorder is caused when a single copy of the mutant allele is present. Males and females are affected equally, and can both transmit the disorder with a risk of 50% for each child of inheriting the mutant allele. Evidence: PCS. (PMID:23136403)